Phenotypes associated with the disease PURA-related severe neonatal hypotonia-seizures-encephalopathy syndrome due to a point mutation (ORPHA:438216):
- Seizure (HP:0001250): A seizure is an intermittent abnormality of nervous system physiology characterized by a transient occurrence of signs and/or symptoms due to abnormal excessive or synchronous neuronal activity in the brain. Evidence: TAS. Frequency: Very frequent (HP:0040281). (ORPHA:438216)
- Global developmental delay (HP:0001263): A delay in the achievement of motor or mental milestones in the domains of development of a child, including motor skills, speech and language, cognitive skills, and social and emotional skills. This term should only be used to describe children younger than five years of age. Evidence: TAS. Frequency: Very frequent (HP:0040281). (ORPHA:438216)
- Respiratory distress (HP:0002098): Respiratory distress is objectively observable as the physical or emotional consequences from the experience of dyspnea. The physical presentation of respiratory distress is generally referred to as labored breathing, while the sensation of respiratory distress is called shortness of breath or dyspnea. Evidence: TAS. Frequency: Very frequent (HP:0040281). (ORPHA:438216)
- Feeding difficulties in infancy (HP:0008872): Impaired feeding performance of an infant as manifested by difficulties such as weak and ineffective sucking, brief bursts of sucking, and falling asleep during sucking. There may be difficulties with chewing or maintaining attention. Evidence: TAS. Frequency: Very frequent (HP:0040281). (ORPHA:438216)
- Myopathic facies (HP:0002058): A facial appearance characteristic of myopathic conditions. The face appears expressionless with sunken cheeks, bilateral ptosis, and inability to elevate the corners of the mouth, due to muscle weakness. Evidence: TAS. Frequency: Frequent (HP:0040282). (ORPHA:438216)
- Severe global developmental delay (HP:0011344): A severe delay in the achievement of motor or mental milestones in the domains of development of a child. Evidence: TAS. Frequency: Frequent (HP:0040282). (ORPHA:438216)
- High palate (HP:0000218): Height of the palate more than 2 SD above the mean (objective) or palatal height at the level of the first permanent molar more than twice the height of the teeth (subjective). Evidence: TAS. Frequency: Occasional (HP:0040283). (ORPHA:438216)
- Thin upper lip vermilion (HP:0000219): Height of the vermilion of the upper lip in the midline more than 2 SD below the mean. Alternatively, an apparently reduced height of the vermilion of the upper lip in the frontal view (subjective). Evidence: TAS. Frequency: Occasional (HP:0040283). (ORPHA:438216)
- Microcephaly (HP:0000252): Head circumference below 2 standard deviations below the mean for age and gender. Evidence: TAS. Frequency: Occasional (HP:0040283). (ORPHA:438216)
- Long face (HP:0000276): Facial height (length) is more than 2 standard deviations above the mean (objective); or, an apparent increase in the height (length) of the face (subjective). Evidence: TAS. Frequency: Occasional (HP:0040283). (ORPHA:438216)
- Epicanthus (HP:0000286): A fold of skin starting above the medial aspect of the upper eyelid and arching downward to cover, pass in front of and lateral to the medial canthus. Evidence: TAS. Frequency: Occasional (HP:0040283). (ORPHA:438216)
- Full cheeks (HP:0000293): Increased prominence or roundness of soft tissues between zygomata and mandible. Evidence: TAS. Frequency: Occasional (HP:0040283). (ORPHA:438216)
- Facial hypotonia (HP:0000297): Reduced muscle tone of a muscle that is innervated by the facial nerve (the seventh cranial nerve). Evidence: TAS. Frequency: Occasional (HP:0040283). (ORPHA:438216)
- Facial asymmetry (HP:0000324): An abnormal difference between the left and right sides of the face. Evidence: TAS. Frequency: Occasional (HP:0040283). (ORPHA:438216)
- High forehead (HP:0000348): An abnormally increased height of the forehead. Evidence: TAS. Frequency: Occasional (HP:0040283). (ORPHA:438216)
- Abnormal pinna morphology (HP:0000377): An abnormality of the pinna, which is also referred to as the auricle or external ear. Evidence: TAS. Frequency: Occasional (HP:0040283). (ORPHA:438216)
- Underdeveloped nasal alae (HP:0000430): Thinned, deficient, or excessively arched ala nasi. Evidence: TAS. Frequency: Occasional (HP:0040283). (ORPHA:438216)
- Wide nasal bridge (HP:0000431): Increased breadth of the nasal bridge (and with it, the nasal root). Evidence: TAS. Frequency: Occasional (HP:0040283). (ORPHA:438216)
- Broad nasal tip (HP:0000455): Increase in width of the nasal tip. Evidence: TAS. Frequency: Occasional (HP:0040283). (ORPHA:438216)
- Anteverted nares (HP:0000463): Anteriorly-facing nostrils viewed with the head in the Frankfurt horizontal and the eyes of the observer level with the eyes of the subject. This gives the appearance of an upturned nose (upturned nasal tip). Evidence: TAS. Frequency: Occasional (HP:0040283). (ORPHA:438216)
- Telecanthus (HP:0000506): Distance between the inner canthi more than two standard deviations above the mean (objective); or, apparently increased distance between the inner canthi. Evidence: TAS. Frequency: Occasional (HP:0040283). (ORPHA:438216)
- Myopia (HP:0000545): An abnormality of refraction characterized by the ability to see objects nearby clearly, while objects in the distance appear blurry. Evidence: TAS. Frequency: Occasional (HP:0040283). (ORPHA:438216)
- Upslanted palpebral fissure (HP:0000582): The palpebral fissure inclination is more than two standard deviations above the mean for age (objective); or, the inclination of the palpebral fissure is greater than typical for age. Evidence: TAS. Frequency: Occasional (HP:0040283). (ORPHA:438216)
- Long palpebral fissure (HP:0000637): Distance between medial and lateral canthi is more than two standard deviations above the mean for age (objective); or, apparently increased length of the palpebral fissures. Evidence: TAS. Frequency: Occasional (HP:0040283). (ORPHA:438216)
- Short attention span (HP:0000736): Reduced attention span characterized by distractibility and impulsivity. Evidence: TAS. Frequency: Occasional (HP:0040283). (ORPHA:438216)
- Anxiety (HP:0000739): Intense feelings of nervousness, tension, or panic often arise in response to interpersonal stresses. There is worry about the negative effects of past unpleasant experiences and future negative possibilities. Individuals may feel fearful, apprehensive, or threatened by uncertainty, and they may also have fears of falling apart or losing control. Evidence: TAS. Frequency: Occasional (HP:0040283). (ORPHA:438216)
- Ataxia (HP:0001251): Ataxia refers to impaired coordination of voluntary muscle movement. Cerebellar ataxia refers to ataxia due to dysfunction of the cerebellum. This causes a variety of elementary neurological deficits including asynergy (lack of coordination between muscles, limbs and joints), dysmetria (lack of ability to judge distances that can lead to under- or overshoot in grasping movements), and dysdiadochokinesia (inability to perform rapid movements requiring antagonizing muscle groups to be switched on and off repeatedly). Evidence: TAS. Frequency: Occasional (HP:0040283). (ORPHA:438216)
- Dystonia (HP:0001332): An abnormally increased muscular tone that causes fixed abnormal postures. There is a slow, intermittent twisting motion that leads to exaggerated turning and posture of the extremities and trunk. Evidence: TAS. Frequency: Occasional (HP:0040283). (ORPHA:438216)
- Frontal bossing (HP:0002007): Bilateral bulging of the lateral frontal bone prominences with relative sparing of the midline. Evidence: TAS. Frequency: Occasional (HP:0040283). (ORPHA:438216)
- Broad-based gait (HP:0002136): An abnormal gait pattern in which persons stand and walk with their feet spaced widely apart. This is often a component of cerebellar ataxia. Evidence: TAS. Frequency: Occasional (HP:0040283). (ORPHA:438216)
- Exaggerated startle response (HP:0002267): An exaggerated startle reaction in response to a sudden unexpected visual or acoustic stimulus, or a quick movement near the face. Evidence: TAS. Frequency: Occasional (HP:0040283). (ORPHA:438216)
- Abnormal primary tooth morphology (HP:0006481): Any abnormality of the primary tooth. Evidence: TAS. Frequency: Occasional (HP:0040283). (ORPHA:438216)
- Severe muscular hypotonia (HP:0006829): A severe degree of muscular hypotonia characterized by markedly reduced muscle tone. Evidence: TAS. Frequency: Occasional (HP:0040283). (ORPHA:438216)
- Tented upper lip vermilion (HP:0010804): Triangular appearance of the oral aperture with the apex in the midpoint of the upper vermilion and the lower vermilion forming the base. Evidence: TAS. Frequency: Occasional (HP:0040283). (ORPHA:438216)
- Incisor macrodontia (HP:0011081): Increased size of the incisor tooth. Evidence: TAS. Frequency: Occasional (HP:0040283). (ORPHA:438216)
- Prominent forehead (HP:0011220): Forward prominence of the entire forehead, due to protrusion of the frontal bone. Evidence: TAS. Frequency: Occasional (HP:0040283). (ORPHA:438216)
- Handgrip myotonia (HP:0012899): Difficulty releasing one's grip associated with prolonged first handgrip relaxation times. Evidence: TAS. Frequency: Occasional (HP:0040283). (ORPHA:438216)
- Dyskinesia (HP:0100660): A movement disorder which consists of effects including diminished voluntary movements and the presence of involuntary movements. Evidence: TAS. Frequency: Occasional (HP:0040283). (ORPHA:438216)